- Hypotonia (HP:0001252): Hypotonia is an abnormally low muscle tone (the amount of tension or resistance to movement in a muscle). Even when relaxed, muscles have a continuous and passive partial contraction which provides some resistance to passive stretching. Hypotonia thus manifests as diminished resistance to passive stretching. Hypotonia is not the same as muscle weakness, although the two conditions can co-exist. Evidence: TAS. Frequency: Frequent (HP:0040282). (ORPHA:137754)
- Encephalopathy (HP:0001298): Encephalopathy is a term that means brain disease, damage, or malfunction. In general, encephalopathy is manifested by an altered mental state. Evidence: TAS. Frequency: Frequent (HP:0040282). (ORPHA:137754)
- Generalized muscle weakness (HP:0003324): Generalized weakness or decreased strength of the muscles, affecting both distal and proximal musculature. Evidence: TAS. Frequency: Frequent (HP:0040282). (ORPHA:137754)
- Seizure (HP:0001250): A seizure is an intermittent abnormality of nervous system physiology characterized by a transient occurrence of signs and/or symptoms due to abnormal excessive or synchronous neuronal activity in the brain. Evidence: TAS. Frequency: Occasional (HP:0040283). (ORPHA:137754)
- Global developmental delay (HP:0001263): A delay in the achievement of motor or mental milestones in the domains of development of a child, including motor skills, speech and language, cognitive skills, and social and emotional skills. This term should only be used to describe children younger than five years of age. Evidence: TAS. Frequency: Occasional (HP:0040283). (ORPHA:137754)
- Vomiting (HP:0002013): Forceful ejection of the contents of the stomach through the mouth by means of a series of involuntary spasmic contractions. Evidence: TAS. Frequency: Occasional (HP:0040283). (ORPHA:137754)
- Apnea (HP:0002104): Lack of breathing with no movement of the respiratory muscles and no exchange of air in the lungs. This term refers to a disposition to have recurrent episodes of apnea rather than to a single event. Evidence: TAS. Frequency: Occasional (HP:0040283). (ORPHA:137754)
- Syringomyelia (HP:0003396): Dilated, glial-lined cavity in spinal cord. This cavity does not communicate with the central canal, and usually is between the dorsal columns unilaterally or bilaterally along the side of the cord. Evidence: TAS. Frequency: Occasional (HP:0040283). (ORPHA:137754)
- Aplasia/Hypoplasia of the cerebellar vermis (HP:0006817): Absence or underdevelopment of the vermis of cerebellum. Evidence: TAS. Frequency: Occasional (HP:0040283). (ORPHA:137754)
- Aplasia/Hypoplasia of the corpus callosum (HP:0007370): Absence or underdevelopment of the corpus callosum. Evidence: TAS. Frequency: Occasional (HP:0040283). (ORPHA:137754)
- Hypertelorism (HP:0000316): Interpupillary distance more than 2 SD above the mean (alternatively, the appearance of an increased interpupillary distance or widely spaced eyes). Evidence: TAS. Frequency: Very rare (HP:0040284). (ORPHA:137754)
- Sensorineural hearing impairment (HP:0000407): A type of hearing impairment in one or both ears related to an abnormal functionality of the cochlear nerve. Evidence: TAS. Frequency: Very rare (HP:0040284). (ORPHA:137754)
- Wide nose (HP:0000445): Interalar distance more than two standard deviations above the mean for age, i.e., an apparently increased width of the nasal base and alae. Evidence: TAS. Frequency: Very rare (HP:0040284). (ORPHA:137754)
These phenotypes are associated with the disease Aminoacylase 1 deficiency (ORPHA:137754).